Phenotypes associated with the disease Epithelial recurrent erosion dystrophy (ORPHA:293381):
- Ocular pain (HP:0200026): An unpleasant sensation characterized by physical discomfort (such as pricking, throbbing, or aching) localized to the eye. Evidence: TAS. Frequency: Very frequent (HP:0040281). (ORPHA:293381)
- Epiphora (HP:0009926): Abnormally increased lacrimation, that is, excessive tearing (watering eye). Evidence: TAS. Frequency: Occasional (HP:0040283). (ORPHA:293381)
- Photophobia (HP:0000613): Excessive sensitivity to light with the sensation of discomfort or pain in the eyes due to exposure to bright light. Evidence: TAS. Frequency: Frequent (HP:0040282). (ORPHA:293381)
- Corneal dystrophy (HP:0001131): The term corneal dystrophy embraces a heterogenous group of bilateral genetically determined non-inflammatory corneal diseases that are restricted to the cornea. Evidence: TAS. Frequency: Very frequent (HP:0040281). (ORPHA:293381)
- Blurred vision (HP:0000622): Lack of sharpness of vision resulting in the inability to see fine detail. Evidence: TAS. Frequency: Frequent (HP:0040282). (ORPHA:293381)
- Subepithelial corneal opacities (HP:0008039). Evidence: TAS. Frequency: Very frequent (HP:0040281). (ORPHA:293381)
- Recurrent corneal erosions (HP:0000495): The presence of recurrent corneal epithelial erosions. Although most corneal epithelial defects heal quickly, some may show recurrent ulcerations. Evidence: TAS. Frequency: Very frequent (HP:0040281). (ORPHA:293381)
- Corneal scarring (HP:0000559). Evidence: TAS. Frequency: Frequent (HP:0040282). (ORPHA:293381)
- Progressive visual loss (HP:0000529): A reduction of previously attained ability to see. Evidence: TAS. Frequency: Very frequent (HP:0040281). (ORPHA:293381)
- Irregular astigmatism (HP:0031792): A type of astigmatism in which the principle meridians are not 90 degrees apart and which is associated with loss of vision. Evidence: TAS. Frequency: Frequent (HP:0040282). (ORPHA:293381)
- Keratoconjunctivitis sicca (HP:0001097): Dryness of the eye related to deficiency of the tear film components (aqueous, mucin, or lipid), lid surface abnormalities, or epithelial abnormalities. Keratoconjunctivitis sicca often results in a scratchy or sandy sensation (foreign body sensation) in the eyes, and may also be associated with itching, inability to produce tears, photosensitivity, redness, pain, and difficulty in moving the eyelids. Evidence: TAS. Frequency: Occasional (HP:0040283). (ORPHA:293381)